Phenotypes associated with the disease second branchial cleft anomaly (OMIM:113600):
- Abnormality of the neck (HP:0000464): An abnormality of the neck. Evidence: IEA. (OMIM:113600)
- Autosomal dominant inheritance (HP:0000006): A mode of inheritance that is observed for traits related to a gene encoded on one of the autosomes (i.e., the human chromosomes 1-22) in which a trait manifests in heterozygotes. In the context of medical genetics, an autosomal dominant disorder is caused when a single copy of the mutant allele is present. Males and females are affected equally, and can both transmit the disorder with a risk of 50% for each child of inheriting the mutant allele. Evidence: IEA. (OMIM:113600)